- Congenital onset (HP:0003577): A phenotypic abnormality that is present at birth. Evidence: PCS. Frequency: 3/9. (PMID:26340333)
- Strabismus (HP:0000486): A misalignment of the eyes so that the visual axes deviate from bifoveal fixation. The classification of strabismus may be based on a number of features including the relative position of the eyes, whether the deviation is latent or manifest, intermittent or constant, concomitant or otherwise and according to the age of onset and the relevance of any associated refractive error. Evidence: PCS. Frequency: 5/9. (PMID:26340333)
- Cerebellar atrophy (HP:0001272): Cerebellar atrophy is defined as a cerebellum with initially normal structures, in a posterior fossa with normal size, which displays enlarged fissures (interfolial spaces) in comparison to the foliae secondary to loss of tissue. Cerebellar atrophy implies irreversible loss of tissue and result from an ongoing progressive disease until a final stage is reached or a single injury, e.g. an intoxication or infectious event. Evidence: PCS. (PMID:26340333)
- Spina bifida occulta (HP:0003298): The closed form of spina bifida with incomplete closure of a vertebral body with intact overlying skin. Evidence: PCS. Frequency: 1/9. (PMID:26340333)
- Agenesis of corpus callosum (HP:0001274): Absence of the corpus callosum as a result of the failure of the corpus callosum to develop, which can be the result of a failure in any one of the multiple steps of callosal development including cellular proliferation and migration, axonal growth or glial patterning at the midline. Evidence: PCS. Frequency: 1/9. (PMID:26340333)
- Hypotonia (HP:0001252): Hypotonia is an abnormally low muscle tone (the amount of tension or resistance to movement in a muscle). Even when relaxed, muscles have a continuous and passive partial contraction which provides some resistance to passive stretching. Hypotonia thus manifests as diminished resistance to passive stretching. Hypotonia is not the same as muscle weakness, although the two conditions can co-exist. Evidence: PCS. Frequency: 3/9. (PMID:26340333)
- Turricephaly (HP:0000262): Tall head relative to width and length. Evidence: TAS. Frequency: 1/9. (OMIM:616602)
- Infantile onset (HP:0003593): Onset of signs or symptoms of disease between 28 days to one year of life. Evidence: PCS. Frequency: 6/9. (PMID:26340333)
- Bicoronal synostosis (HP:0011318): Synostosis affecting the right and the left coronal suture. Evidence: PCS. Frequency: 6/9. (PMID:26340333)
- Hypertelorism (HP:0000316): Interpupillary distance more than 2 SD above the mean (alternatively, the appearance of an increased interpupillary distance or widely spaced eyes). Evidence: PCS. Frequency: 1/9. (PMID:26340333)
- Dandy-Walker malformation (HP:0001305): A congenital brain malformation typically characterized by incomplete formation of the cerebellar vermis, dilation of the fourth ventricle, and enlargement of the posterior fossa. In layman's terms, Dandy Walker malformation is a cyst in the cerebellum (typically symmetrical) that is involved with the fourth ventricle. This may interfere with the ability to drain cerebrospinal fluid from the brain, resulting in hydrocephalus. Dandy Walker cysts are formed during early embryonic development, while the brain forms. The cyst in the cerebellum typically has several blood vessels running through it connecting to the brain, thereby prohibiting surgical removal. Evidence: PCS. Frequency: 1/9. (PMID:26340333)
- Craniosynostosis (HP:0001363): Craniosynostosis refers to the premature closure of the cranial sutures. Primary craniosynostosis refers to the closure of one or more sutures due to abnormalities in skull development, and secondary craniosynostosis results from failure of brain growth. Evidence: PCS. Frequency: 9/9. (PMID:26340333)
- Microcephaly (HP:0000252): Head circumference below 2 standard deviations below the mean for age and gender. Evidence: PCS. Frequency: 3/9. (PMID:26340333)
- Parietal foramina (HP:0002697): The presence of symmetrical and circular openings (foramina) in the parietal bone ranging in size from a few millimeters to several centimeters wide. Evidence: PCS. Frequency: 1/9. (PMID:26340333)
- Lateral ventricle dilatation (HP:0006956). Evidence: PCS. Frequency: 2/9. (PMID:26340333)
- Scoliosis (HP:0002650): The presence of an abnormal lateral curvature of the spine. Evidence: PCS. Frequency: 2/9. (PMID:26340333)
- Delayed cranial suture closure (HP:0000270): Infants normally have two fontanels at birth, the diamond-shaped anterior fontanelle at the junction of the coronal and sagittal sutures, and the posterior fontanelle at the intersection of the occipital and parietal bones. The posterior fontanelle usually closes by the 8th week of life, and the anterior fontanel closes by the 18th month of life on average. This term applies if there is delay of closure of the fontanelles beyond the normal age. Evidence: PCS. Frequency: 2/9. (PMID:26340333)
- Global developmental delay (HP:0001263): A delay in the achievement of motor or mental milestones in the domains of development of a child, including motor skills, speech and language, cognitive skills, and social and emotional skills. This term should only be used to describe children younger than five years of age. Evidence: PCS. (PMID:26340333)
- Low anterior hairline (HP:0000294): Distance between the hairline (trichion) and the glabella (the most prominent point on the frontal bone above the root of the nose), in the midline, more than two SD below the mean. Alternatively, an apparently decreased distance between the hairline and the glabella. Evidence: PCS. Frequency: 2/9. (PMID:26340333)
- Right unilambdoid synostosis (HP:0011322): Premature synostosis of only the right lambdoid suture. Evidence: PCS. Frequency: 1/9. (PMID:26340333)
- Sensorineural hearing impairment (HP:0000407): A type of hearing impairment in one or both ears related to an abnormal functionality of the cochlear nerve. Evidence: PCS. Frequency: 1/9. (PMID:26340333)
- Ptosis (HP:0000508): The upper eyelid margin is positioned 3 mm or more lower than usual and covers the superior portion of the iris (objective); or, the upper lid margin obscures at least part of the pupil (subjective). Evidence: PCS. Frequency: 3/9. (PMID:26340333)
- High forehead (HP:0000348): An abnormally increased height of the forehead. Evidence: PCS. Frequency: 3/9. (PMID:26340333)
- Plagiocephaly (HP:0001357): Asymmetric head shape, which is usually a combination of unilateral occipital flattening with ipsilateral frontal prominence, leading to rhomboid cranial shape. Evidence: PCS. Frequency: 1/9. (PMID:26340333)
- Autosomal dominant inheritance (HP:0000006): A mode of inheritance that is observed for traits related to a gene encoded on one of the autosomes (i.e., the human chromosomes 1-22) in which a trait manifests in heterozygotes. In the context of medical genetics, an autosomal dominant disorder is caused when a single copy of the mutant allele is present. Males and females are affected equally, and can both transmit the disorder with a risk of 50% for each child of inheriting the mutant allele. Evidence: PCS. (PMID:26340333)
- Brachycephaly (HP:0000248): An abnormality of skull shape characterized by a decreased anterior-posterior diameter. That is, a cephalic index greater than 81%. Alternatively, an apparently shortened anteroposterior dimension (length) of the head compared to width. Evidence: PCS. Frequency: 1/9. (PMID:26340333)
These phenotypes are associated with the disease craniosynostosis 6 (OMIM:616602).